- Alopecia of scalp (HP:0002293). Evidence: TAS. Frequency: Very frequent (HP:0040281). (ORPHA:700)
- Alopecia totalis (HP:0007418): Loss of all scalp hair. Evidence: TAS. Frequency: Very frequent (HP:0040281). (ORPHA:700)
- Vitiligo (HP:0001045). Evidence: TAS. Frequency: Occasional (HP:0040283). (ORPHA:700)
- Nail pits (HP:0001803): Small (typically about 1 mm or less in size) depressions on the dorsal nail surface. Evidence: TAS. Frequency: Occasional (HP:0040283). (ORPHA:700)
- Onycholysis (HP:0001806): Detachment of the nail from the nail bed. Evidence: TAS. Frequency: Occasional (HP:0040283). (ORPHA:700)
- Fragile nails (HP:0001808): Nails that easily break. Evidence: TAS. Frequency: Occasional (HP:0040283). (ORPHA:700)
- Inflammation of the large intestine (HP:0002037): Inflammation, or an inflammatory state in the large intestine. Evidence: TAS. Frequency: Occasional (HP:0040283). (ORPHA:700)
- Autoimmunity (HP:0002960): The occurrence of an immune reaction against the organism's own cells or tissues. Evidence: TAS. Frequency: Occasional (HP:0040283). (ORPHA:700)
- Trachyonychia (HP:0030804): Excessive longitudinal ridging that gives the surface of the nail plate a rough appearance. It results from multiple foci of defective keratinization of the proximal nail matrix. Evidence: TAS. Frequency: Occasional (HP:0040283). (ORPHA:700)
- Type I diabetes mellitus (HP:0100651): A chronic condition in which the pancreas produces little or no insulin. Type I diabetes mellitus is manifested by the sudden onset of severe hyperglycemia with rapid progression to diabetic ketoacidosis unless treated with insulin. Evidence: TAS. Frequency: Occasional (HP:0040283). (ORPHA:700)
These phenotypes are associated with the disease Alopecia totalis (ORPHA:700).